Phenotypes associated with the disease optic atrophy 15 (OMIM:620583):
- Juvenile onset (HP:0003621): Onset of signs or symptoms of disease between the age of 5 and 15 years. Evidence: PCS. Frequency: 2/2. (PMID:31915829)
- Nystagmus (HP:0000639): Rhythmic, involuntary oscillations of one or both eyes related to abnormality in fixation, conjugate gaze, or vestibular mechanisms. Evidence: PCS. Frequency: 2/2. (PMID:31915829)
- Young adult onset (HP:0011462): Onset of disease at the age of between 16 and 40 years. Evidence: PCS. Frequency: 1/1. (PMID:33918393)
- Photophobia (HP:0000613): Excessive sensitivity to light with the sensation of discomfort or pain in the eyes due to exposure to bright light. Evidence: PCS. Frequency: 1/1. (PMID:33918393)
- Autosomal recessive inheritance (HP:0000007): A mode of inheritance that is observed for traits related to a gene encoded on one of the autosomes (i.e., the human chromosomes 1-22) in which a trait manifests in individuals with two pathogenic alleles, either homozygotes (two copies of the same mutant allele) or compound heterozygotes (whereby each copy of a gene has a distinct mutant allele). Evidence: PCS. (PMID:31915829)
- Reduced visual acuity (HP:0007663). Evidence: PCS. Frequency: 1/1. (PMID:33918393)
- Dyschromatopsia (HP:0007641): A form of colorblindness in which only two of the three fundamental colors can be distinguished due to a lack of one of the retinal cone pigments. Evidence: PCS. Frequency: 1/1. (PMID:33918393)
- Optic atrophy (HP:0000648): Atrophy of the optic nerve. Optic atrophy results from the death of the retinal ganglion cell axons that comprise the optic nerve and manifesting as a pale optic nerve on fundoscopy. Evidence: PCS. Frequency: 3/3. (PMID:31915829;PMID:33918393)
- Central scotoma (HP:0000603): An area of depressed vision located at the point of fixation and that interferes with central vision. Evidence: PCS. Frequency: 1/1. (PMID:33918393)
- Optic disc pallor (HP:0000543): A pale yellow discoloration of the optic disc (the area of the optic nerve head in the retina). The optic disc normally has a pinkish hue with a central yellowish depression. Evidence: PCS. Frequency: 2/2. (PMID:31915829)
- Headache (HP:0002315): Cephalgia, or pain sensed in various parts of the head, not confined to the area of distribution of any nerve. Evidence: PCS. Frequency: 1/1. (PMID:33918393)